- Epicanthus (HP:0000286): A fold of skin starting above the medial aspect of the upper eyelid and arching downward to cover, pass in front of and lateral to the medial canthus. Evidence: PCS. Frequency: 1/2. (PMID:33711248)
- Delayed speech and language development (HP:0000750): A degree of language development that is significantly below the norm for a child of a specified age. Evidence: PCS. Frequency: 2/2. (PMID:33711248)
- Delayed CNS myelination (HP:0002188): Delayed myelination in the central nervous system. Evidence: PCS. Frequency: 1/2. (PMID:33711248)
- Short stature (HP:0004322): A height below that which is expected according to age and gender norms. Although there is no universally accepted definition of short stature, many refer to "short stature" as height more than 2 standard deviations below the mean for age and gender (or below the 3rd percentile for age and gender dependent norms). Evidence: PCS. Frequency: 1/2. (PMID:33711248)
- Delayed ability to walk (HP:0031936): A failure to achieve the ability to walk at an appropriate developmental stage. Most children learn to walk in a series of stages, and learn to walk short distances independently between 12 and 15 months. Evidence: PCS. Frequency: 2/2. (PMID:33711248)
- Infantile onset (HP:0003593): Onset of signs or symptoms of disease between 28 days to one year of life. Evidence: PCS. Frequency: 2/2. (PMID:33711248)
- Myoclonic seizure (HP:0032794): A myoclonic seizure is a type of motor seizure characterized by sudden, brief (<100 ms) involuntary single or multiple contraction of muscles or muscle groups of variable topography (axial, proximal limb, distal). Myoclonus is less regularly repetitive and less sustained than is clonus. Evidence: PCS. Frequency: 1/2. (PMID:33711248)
- Epileptic spasm (HP:0011097): A sudden flexion, extension, or mixed extension-flexion of predominantly proximal and truncal muscles that is usually more sustained than a myoclonic movement but not as sustained as a tonic seizure. Limited forms may occur: Grimacing, head nodding, or subtle eye movements. Epileptic spasms frequently occur in clusters. Infantile spasms are the best known form, but spasms can occur at all ages. Evidence: PCS. Frequency: 2/2. (PMID:33711248)
- Hypertelorism (HP:0000316): Interpupillary distance more than 2 SD above the mean (alternatively, the appearance of an increased interpupillary distance or widely spaced eyes). Evidence: PCS. Frequency: 1/2. (PMID:33711248)
- High palate (HP:0000218): Height of the palate more than 2 SD above the mean (objective) or palatal height at the level of the first permanent molar more than twice the height of the teeth (subjective). Evidence: PCS. Frequency: 1/2. (PMID:33711248)
- Esotropia (HP:0000565): A form of strabismus with one or both eyes turned inward ('crossed') to a relatively severe degree, usually defined as 10 diopters or more. Evidence: PCS. Frequency: 1/2. (PMID:33711248)
- Focal-onset seizure (HP:0007359): A focal-onset seizure is a type of seizure originating within networks limited to one hemisphere. They may be discretely localized or more widely distributed, and may originate in subcortical structures. Evidence: PCS. Frequency: 1/2. (PMID:33711248)
- Autosomal dominant inheritance (HP:0000006): A mode of inheritance that is observed for traits related to a gene encoded on one of the autosomes (i.e., the human chromosomes 1-22) in which a trait manifests in heterozygotes. In the context of medical genetics, an autosomal dominant disorder is caused when a single copy of the mutant allele is present. Males and females are affected equally, and can both transmit the disorder with a risk of 50% for each child of inheriting the mutant allele. Evidence: PCS. (PMID:33711248)
- Intellectual disability (HP:0001249): The term intellectual disability or intellectual developmental disorder is used to describe significantly sub-average intellectual and adaptive functioning based on clinical assessment and as measured by individually administered, appropriately normed, standardized and validated tests of intellectual functioning and adaptive behavior, with onset during the developmental period from infancy through adolescence. Evidence: PCS. Frequency: 2/2. (PMID:33711248)
These phenotypes are associated with the disease neurodevelopmental disorder with infantile epileptic spasms (OMIM:619373).